Phenotypes associated with the disease Idiopathic/heritable pulmonary arterial hypertension (ORPHA:422):
- Pulmonary arterial hypertension (HP:0002092): Pulmonary hypertension is defined mean pulmonary artery pressure of 25mmHg or more and pulmonary capillary wedge pressure of 15mmHg or less when measured by right heart catheterisation at rest and in a supine position. Evidence: TAS. Frequency: Very frequent (HP:0040281). (ORPHA:422)
- Dyspnea (HP:0002094): Difficult or labored breathing. Dyspnea is a subjective feeling only the patient can rate, e.g., on a Borg scale. Evidence: TAS. Frequency: Frequent (HP:0040282). (ORPHA:422)
- Abnormal cardiovascular system physiology (HP:0011025): Abnormal functionality of the cardiovascular system. Evidence: TAS. Frequency: Frequent (HP:0040282). (ORPHA:422)
- Syncope (HP:0001279): A transient loss of consciousness (i.e., characterized by a rapid onset, a short duration, and a spontaneous and complete recovery) due to cerebral hypoperfusion. Evidence: TAS. Frequency: Occasional (HP:0040283). (ORPHA:422)
- Palpitations (HP:0001962): A sensation that the heart is pounding or racing, which is a non-specific sign but may be a manifestation of arrhythmia. Evidence: TAS. Frequency: Occasional (HP:0040283). (ORPHA:422)
- Hepatomegaly (HP:0002240): Abnormally increased size of the liver. Evidence: TAS. Frequency: Occasional (HP:0040283). (ORPHA:422)
- Right ventricular dilatation (HP:0005133): Enlargement of the chamber of the right ventricle, which can be defined echocardiographically as a right ventricular to left ventricular ratio greater than 1:1. Evidence: TAS. Frequency: Occasional (HP:0040283). (ORPHA:422)
- Tricuspid regurgitation (HP:0005180): Failure of the tricuspid valve to close sufficiently upon contraction of the right ventricle, causing blood to regurgitate (flow backward) into the right atrium. Evidence: TAS. Frequency: Occasional (HP:0040283). (ORPHA:422)
- Fatigue (HP:0012378): A subjective feeling of tiredness characterized by a lack of energy and motivation. Evidence: TAS. Frequency: Occasional (HP:0040283). (ORPHA:422)
- Heart murmur (HP:0030148): An extra or unusual sound heard during a heartbeat caused vibrations resulting from the flow of blood through the heart. Evidence: TAS. Frequency: Occasional (HP:0040283). (ORPHA:422)
- Elevated jugular venous pressure (HP:0030848): Increased jugular venous pressure. Evidence: TAS. Frequency: Occasional (HP:0040283). (ORPHA:422)
- Chest pain (HP:0100749): An unpleasant sensation characterized by physical discomfort (such as pricking, throbbing, or aching) localized to the chest. Evidence: TAS. Frequency: Occasional (HP:0040283). (ORPHA:422)
- Pedal edema (HP:0010741): An abnormal accumulation of excess fluid in the lower extremity resulting in swelling of the feet and extending upward to the lower leg. Evidence: TAS. Frequency: Very rare (HP:0040284). (ORPHA:422)